Phenotypes associated with the disease Tako-Tsubo cardiomyopathy (ORPHA:66529):
- Mildly reduced left ventricular ejection fraction (HP:0012663): A small reduction in the fraction of blood pumped from the left ventricle with each cardiac cycle. The normal range in adults is at least 50 percent, and a mild reduction is defined as 40-49 percent. Evidence: TAS. Frequency: Very frequent (HP:0040281). (ORPHA:66529)
- T-wave inversion (HP:0010872): An inversion of the T-wave (which is normally positive). Evidence: TAS. Frequency: Frequent (HP:0040282). (ORPHA:66529)
- ST segment elevation (HP:0012251): An electrocardiographic anomaly in which the ST segment is observed to be located superior to the isoelectric line. Evidence: TAS. Frequency: Frequent (HP:0040282). (ORPHA:66529)
- Reduced contraction of the left ventricular apex (HP:0031483): Reduced wall motion (contraction) of the apex of the left ventricle. This manifestation can be observed on echocardiography. Evidence: TAS. Frequency: Frequent (HP:0040282). (ORPHA:66529)
- Chest pain (HP:0100749): An unpleasant sensation characterized by physical discomfort (such as pricking, throbbing, or aching) localized to the chest. Evidence: TAS. Frequency: Frequent (HP:0040282). (ORPHA:66529)
- Increased circulating troponin T concentration (HP:0410174): An increased concentration of tropnin T in the blood, which is a cardiac regulatory protein that controls the calcium mediated interaction between actin and myosin. Raised cardiac troponin concentrations are now accepted as the standard biochemical marker for the diagnosis of myocardial infarction. Evidence: TAS. Frequency: Frequent (HP:0040282). (ORPHA:66529)
- Hypertension (HP:0000822): The presence of chronic increased pressure in the systemic arterial system. Evidence: TAS. Frequency: Occasional (HP:0040283). (ORPHA:66529)
- Obesity (HP:0001513): Accumulation of substantial excess body fat. Evidence: TAS. Frequency: Occasional (HP:0040283). (ORPHA:66529)
- Prolonged QT interval (HP:0001657): Increased time between the start of the Q wave and the end of the T wave as measured by the electrocardiogram (EKG). Evidence: TAS. Frequency: Occasional (HP:0040283). (ORPHA:66529)
- Angina pectoris (HP:0001681): Paroxysmal chest pain that occurs with exertion or stress and is related to myocardial ischemia. Evidence: TAS. Frequency: Occasional (HP:0040283). (ORPHA:66529)
- Palpitations (HP:0001962): A sensation that the heart is pounding or racing, which is a non-specific sign but may be a manifestation of arrhythmia. Evidence: TAS. Frequency: Occasional (HP:0040283). (ORPHA:66529)
- Vomiting (HP:0002013): Forceful ejection of the contents of the stomach through the mouth by means of a series of involuntary spasmic contractions. Evidence: TAS. Frequency: Occasional (HP:0040283). (ORPHA:66529)
- Dyspnea (HP:0002094): Difficult or labored breathing. Dyspnea is a subjective feeling only the patient can rate, e.g., on a Borg scale. Evidence: TAS. Frequency: Occasional (HP:0040283). (ORPHA:66529)
- Hypotension (HP:0002615): Low Blood Pressure, vascular hypotension. Evidence: TAS. Frequency: Occasional (HP:0040283). (ORPHA:66529)
- Prolonged QTc interval (HP:0005184): A longer than normal interval (corrected for heart rate) between the Q and T waves in the heart's cycle. Prolonged QTc can cause premature action potentials during late phase depolarizations thereby leading to ventricular arrhythmias and ventricular fibrillations. Evidence: TAS. Frequency: Occasional (HP:0040283). (ORPHA:66529)
- Dilatation of the ventricular cavity (HP:0006698): A localized outpouching of ventricular cavity that is generally associated with dyskinesia and paradoxical expansion during systole. Evidence: TAS. Frequency: Occasional (HP:0040283). (ORPHA:66529)
- Mildly elevated creatine kinase (HP:0008180). Evidence: TAS. Frequency: Occasional (HP:0040283). (ORPHA:66529)
- Low-output congestive heart failure (HP:0009805): A form of heart failure characterized by reduced cardiac output. This may be seen in patients with heart failure owing to ischemic heart disease, hypertension, cardiomyopathy, and other causes. Evidence: TAS. Frequency: Occasional (HP:0040283). (ORPHA:66529)
- ST segment depression (HP:0012250): An electrocardiographic anomaly in which the ST segment is observed to be located inferior to the isoelectric line. Evidence: TAS. Frequency: Occasional (HP:0040283). (ORPHA:66529)
- Decreased QRS voltage (HP:0025077): Reduced amplitude (height) of the QRS complex of the electrocardiogram (EKG), defined as amplitudes of all the QRS complexes in the limb leads are less than 5 mm or amplitudes of all the QRS complexes in the precordial leads less than 10 mm. Evidence: TAS. Frequency: Occasional (HP:0040283). (ORPHA:66529)
- Abnormal circulating B-type natriuretic peptide concentration (HP:0031138): A deviation from the normal circulating concentration of B-type natriuretic peptide (BNP). Evidence: TAS. Frequency: Occasional (HP:0040283). (ORPHA:66529)
- Left ventricular apical dyskinesis (HP:6001073): Dyskinesis is used to describe ventricular muscle segments that bulge outside the left ventricular cavity during systole, as opposed to contracting inwards with the rest of the segments. Evidence: TAS. Frequency: Occasional (HP:0040283). (ORPHA:66529)
- Seizure (HP:0001250): A seizure is an intermittent abnormality of nervous system physiology characterized by a transient occurrence of signs and/or symptoms due to abnormal excessive or synchronous neuronal activity in the brain. Evidence: TAS. Frequency: Very rare (HP:0040284). (ORPHA:66529)
- Syncope (HP:0001279): A transient loss of consciousness (i.e., characterized by a rapid onset, a short duration, and a spontaneous and complete recovery) due to cerebral hypoperfusion. Evidence: TAS. Frequency: Very rare (HP:0040284). (ORPHA:66529)
- Mitral regurgitation (HP:0001653): An abnormality of the mitral valve characterized by insufficiency or incompetence of the mitral valve resulting in retrograde leaking of blood through the mitral valve upon ventricular contraction. Evidence: TAS. Frequency: Very rare (HP:0040284). (ORPHA:66529)
- Bradycardia (HP:0001662): A slower than normal heart rate (in adults, slower than 60 beats per minute). Evidence: TAS. Frequency: Very rare (HP:0040284). (ORPHA:66529)
- Ventricular fibrillation (HP:0001663): Uncontrolled contractions of muscles fibers in the left ventricle not producing contraction of the left ventricle. Ventricular fibrillation usually begins with a ventricular premature contraction and a short run of rapid ventricular tachycardia degenerating into uncoordinating ventricular fibrillations. Evidence: TAS. Frequency: Very rare (HP:0040284). (ORPHA:66529)
- Thromboembolic stroke (HP:0001727): A cerebrovascular accident (stroke) that occurs because of thromboembolism. Evidence: TAS. Frequency: Very rare (HP:0040284). (ORPHA:66529)
- Ventricular arrhythmia (HP:0004308). Evidence: TAS. Frequency: Very rare (HP:0040284). (ORPHA:66529)
- Atrial fibrillation (HP:0005110): An atrial arrhythmia characterized by disorganized atrial activity without discrete P waves on the surface EKG, but instead by an undulating baseline or more sharply circumscribed atrial deflections of varying amplitude an frequency ranging from 350 to 600 per minute. Evidence: TAS. Frequency: Very rare (HP:0040284). (ORPHA:66529)
- Arrhythmia (HP:0011675): Any cardiac rhythm other than the normal sinus rhythm. Such a rhythm may be either of sinus or ectopic origin and either regular or irregular. An arrhythmia may be due to a disturbance in impulse formation or conduction or both. Evidence: TAS. Frequency: Very rare (HP:0040284). (ORPHA:66529)
- Cardiogenic shock (HP:0030149): Severely decreased cardiac output with evidence of inadequate end-organ perfusion (i.e., tissue hypoxia) in the presence of adequate intravascular volume. Evidence: TAS. Frequency: Very rare (HP:0040284). (ORPHA:66529)
- Pulmonary edema (HP:0100598): Fluid accumulation in the lungs. Evidence: TAS. Frequency: Very rare (HP:0040284). (ORPHA:66529)
Not associated with this disease:
- Coronary artery atherosclerosis (HP:0001677): Reduction of the diameter of the coronary arteries as the result of an accumulation of atheromatous plaques within the walls of the coronary arteries, which increases the risk of myocardial ischemia. Evidence: TAS. (ORPHA:66529)
- Coronary artery stenosis (HP:0005145): Abnormal narrowing of the coronary artery. Evidence: TAS. (ORPHA:66529)
- Abnormal coronary artery morphology (HP:0006704): Any structural abnormality of the coronary arteries. Evidence: TAS. (ORPHA:66529)
- Myocarditis (HP:0012819): Inflammation of the myocardium. Evidence: TAS. (ORPHA:66529)